Phenotypes associated with the disease chromosome 15q13.3 microdeletion syndrome (OMIM:612001):
- Mild intellectual disability (HP:0001256): Mild intellectual disability (ID) is defined as a type of ID characterized by mildly sub-average adaptive functioning and intellectual functioning, with an intelligence quotient (IQ) the range of 50-69. Evidence: PCS. Frequency: 5/17. (PMID:19372089)
- Moderate intellectual disability (HP:0002342): Moderate intellectual disability (ID) is defined as a type of ID characterized by moderately sub-average adaptive functioning and intellectual functioning, with an intelligence quotient (IQ) the range of 35-49. Evidence: PCS. Frequency: 6/17. (PMID:19372089)
- Strabismus (HP:0000486): A misalignment of the eyes so that the visual axes deviate from bifoveal fixation. The classification of strabismus may be based on a number of features including the relative position of the eyes, whether the deviation is latent or manifest, intermittent or constant, concomitant or otherwise and according to the age of onset and the relevance of any associated refractive error. Evidence: PCS. Frequency: 3/19. (PMID:19372089)
- Brachydactyly (HP:0001156): Digits that appear disproportionately short compared to the hand/foot. The word brachydactyly is used here to describe a series distinct patterns of shortened digits (brachydactyly types A-E). This is the sense used here. Evidence: PCS. Frequency: 3/19. (PMID:19372089)
- Seizure (HP:0001250): A seizure is an intermittent abnormality of nervous system physiology characterized by a transient occurrence of signs and/or symptoms due to abnormal excessive or synchronous neuronal activity in the brain. Evidence: PCS. Frequency: 2/18. (PMID:19372089)
- Hypotonia (HP:0001252): Hypotonia is an abnormally low muscle tone (the amount of tension or resistance to movement in a muscle). Even when relaxed, muscles have a continuous and passive partial contraction which provides some resistance to passive stretching. Hypotonia thus manifests as diminished resistance to passive stretching. Hypotonia is not the same as muscle weakness, although the two conditions can co-exist. Evidence: PCS. Frequency: 9/18. (PMID:19372089)
- Severe intellectual disability (HP:0010864): Severe intellectual disability (ID) is defined as a type of ID characterized by severely sub-average adaptive functioning and intellectual functioning, with an intelligence quotient (IQ) the range of 20-34. Evidence: PCS. Frequency: 3/18. (PMID:19372089)
- Abnormality of the palpebral fissures (HP:0008050): An anomaly of the space between the medial and lateral canthi of the two open eyelids. Evidence: PCS. Frequency: 7/19. (PMID:19372089)
- Atypical behavior (HP:0000708): Atypical behavior is an abnormality in a person's actions that can be controlled or modulated by the will of the individual. While abnormal behaviors can be difficult to control, they are distinct from other abnormal actions that cannot be affected by the individual's will. Evidence: PCS. Frequency: 10/19. (PMID:19372089)
- Typified by incomplete penetrance (HP:0003829): Description of conditions in which not all individuals with a given genotype exhibit the disease. Penetrance is the proportion that develop disease given a lifespan of 80 years. Evidence: PCS. Frequency: 50%. (PMID:19898479)
- Specific learning disability (HP:0001328): Impairment of certain skills such as reading or writing, coordination, self-control, or attention that interfere with the ability to learn. The impairment is not related to a global deficiency of intelligence. Evidence: PCS. Frequency: 7/25. (PMID:19372089)
- Abnormal facial shape (HP:0001999): An abnormal morphology (form) of the face or its components. Evidence: PCS. Frequency: Frequent (HP:0040282). (PMID:19372089)
- Hypertelorism (HP:0000316): Interpupillary distance more than 2 SD above the mean (alternatively, the appearance of an increased interpupillary distance or widely spaced eyes). Evidence: PCS. Frequency: 3/19. (PMID:19372089)
- Abnormal cardiovascular system morphology (HP:0030680): Any structural anomaly of the heart and blood vessels. Evidence: PCS. Frequency: 3/19. (PMID:19372089)
- Clinodactyly of the 5th finger (HP:0004209): Clinodactyly refers to a bending or curvature of the fifth finger in the radial direction (i.e., towards the 4th finger). Evidence: PCS. Frequency: 4/19. (PMID:19372089)
- Synophrys (HP:0000664): Meeting of the medial eyebrows in the midline. Evidence: PCS. Frequency: 3/19. (PMID:19372089)
- Abnormal pinna morphology (HP:0000377): An abnormality of the pinna, which is also referred to as the auricle or external ear. Evidence: PCS. Frequency: 6/19. (PMID:19372089)
- Autosomal dominant inheritance (HP:0000006): A mode of inheritance that is observed for traits related to a gene encoded on one of the autosomes (i.e., the human chromosomes 1-22) in which a trait manifests in heterozygotes. In the context of medical genetics, an autosomal dominant disorder is caused when a single copy of the mutant allele is present. Males and females are affected equally, and can both transmit the disorder with a risk of 50% for each child of inheriting the mutant allele. Evidence: TAS. (OMIM:612001)